Phenotypes associated with the disease Myxopapillary ependymoma (ORPHA:251643):
- Neoplasm of the central nervous system (HP:0100006): A neoplasm of the central nervous system. Evidence: TAS. Frequency: Frequent (HP:0040282). (ORPHA:251643)
- Abnormal sacrum morphology (HP:0005107): An abnormality of the sacral bone. Evidence: TAS. Frequency: Occasional (HP:0040283). (ORPHA:251643)
- Neoplasm of the skin (HP:0008069): A tumor (abnormal growth of tissue) of the skin. Evidence: TAS. Frequency: Occasional (HP:0040283). (ORPHA:251643)
- Abnormal auditory canal morphology (HP:0000372): Any structural abnormality of the external acoustic tube (also known as the auditory canal). Evidence: TAS. Frequency: Very rare (HP:0040284). (ORPHA:251643)
- Ependymoma (HP:0002888): The presence of an ependymoma of the central nervous system. Evidence: TAS. Frequency: Obligate (HP:0040280). (ORPHA:251643)
- Abnormal conus terminalis morphology (HP:0031938): Any structural anomaly of the conus terminalis, which is the distal bulbous part of the spinal cord at the location where the spinal cord tapers and ends (usually between the L1 and L2 lumbar vertebrae). Evidence: TAS. Frequency: Very frequent (HP:0040281). (ORPHA:251643)
- Vomiting (HP:0002013): Forceful ejection of the contents of the stomach through the mouth by means of a series of involuntary spasmic contractions. Evidence: TAS. Frequency: Frequent (HP:0040282). (ORPHA:251643)
- Headache (HP:0002315): Cephalgia, or pain sensed in various parts of the head, not confined to the area of distribution of any nerve. Evidence: TAS. Frequency: Frequent (HP:0040282). (ORPHA:251643)
- Unsteady gait (HP:0002317). Evidence: TAS. Frequency: Frequent (HP:0040282). (ORPHA:251643)
- Autonomic bladder dysfunction (HP:0005341): Abnormal bladder function (increased urge or frequency of urination or urge incontinence) resulting from abnormal functioning of the autonomic nervous system. Evidence: TAS. Frequency: Frequent (HP:0040282). (ORPHA:251643)
- Abnormal large intestine physiology (HP:0012700): A functional anomaly of the large intestine. Evidence: TAS. Frequency: Frequent (HP:0040282). (ORPHA:251643)
- Neck pain (HP:0030833): An unpleasant sensation characterized by physical discomfort (such as pricking, throbbing, or aching) localized to the neck. Evidence: TAS. Frequency: Frequent (HP:0040282). (ORPHA:251643)